Phenotypes associated with the disease cornea plana 1, autosomal dominant (OMIM:121400):
- Autosomal recessive inheritance (HP:0000007): A mode of inheritance that is observed for traits related to a gene encoded on one of the autosomes (i.e., the human chromosomes 1-22) in which a trait manifests in individuals with two pathogenic alleles, either homozygotes (two copies of the same mutant allele) or compound heterozygotes (whereby each copy of a gene has a distinct mutant allele). Evidence: TAS. (OMIM:121400)
- Flat cornea (HP:0007720): Cornea plana is an abnormally flat shape of the cornea such that the normal protrusion of the cornea from the sclera is missing. The reduced corneal curvature can lead to hyperopia, and a hazy corneal limbus and arcus lipoides may develop at an early age. Evidence: IEA. (OMIM:121400)
- Autosomal dominant inheritance (HP:0000006): A mode of inheritance that is observed for traits related to a gene encoded on one of the autosomes (i.e., the human chromosomes 1-22) in which a trait manifests in heterozygotes. In the context of medical genetics, an autosomal dominant disorder is caused when a single copy of the mutant allele is present. Males and females are affected equally, and can both transmit the disorder with a risk of 50% for each child of inheriting the mutant allele. Evidence: TAS. (OMIM:121400)